- Aganglionic megacolon (HP:0002251, a Human Phenotype Ontology term): An abnormality resulting from a lack of intestinal ganglion cells (i.e., an aganglionic section of bowel) that results in bowel obstruction with enlargement of the colon. Evidence: IEA. (OMIM:600156)
- Autosomal dominant inheritance (HP:0000006, a Human Phenotype Ontology term): A mode of inheritance that is observed for traits related to a gene encoded on one of the autosomes (i.e., the human chromosomes 1-22) in which a trait manifests in heterozygotes. In the context of medical genetics, an autosomal dominant disorder is caused when a single copy of the mutant allele is present. Males and females are affected equally, and can both transmit the disorder with a risk of 50% for each child of inheriting the mutant allele. Evidence: TAS. (OMIM:600156)
These phenotypes are associated with the disease Hirschsprung disease, susceptibility to, 5 (OMIM:600156, an entry in Online Mendelian Inheritance in Man).